- Abnormality of the nervous system (HP:0000707): An abnormality of the nervous system. Evidence: TAS. Frequency: Very frequent (HP:0040281). (ORPHA:79239)
- Male infertility (HP:0003251). Evidence: TAS. Frequency: Very frequent (HP:0040281). (ORPHA:79239)
- Abnormal circulating enzyme concentration or activity (HP:0012379): Concentration or activity of an enzyme is above or below the limits of normal in the blood circulation. Evidence: TAS. Frequency: Very frequent (HP:0040281). (ORPHA:79239)
- Abnormal erythrocyte enzyme concentration or activity (HP:0030272): An altered level of any enzyme to act as catalysts within erythrocytes. This term includes changes due to altered activity of an enzyme. Evidence: TAS. Frequency: Very frequent (HP:0040281). (ORPHA:79239)
- Cataract (HP:0000518): A cataract is an opacity or clouding that develops in the crystalline lens of the eye or in its capsule. Evidence: TAS. Frequency: Frequent (HP:0040282). (ORPHA:79239)
- Delayed speech and language development (HP:0000750): A degree of language development that is significantly below the norm for a child of a specified age. Evidence: TAS. Frequency: Frequent (HP:0040282). (ORPHA:79239)
- Primary amenorrhea (HP:0000786). Evidence: TAS. Frequency: Frequent (HP:0040282). (ORPHA:79239)
- Delayed puberty (HP:0000823): Passing the age when puberty normally occurs with no physical or hormonal signs of the onset of puberty. Evidence: TAS. Frequency: Frequent (HP:0040282). (ORPHA:79239)
- Decreased fertility in females (HP:0000868). Evidence: TAS. Frequency: Frequent (HP:0040282). (ORPHA:79239)
- Secondary amenorrhea (HP:0000869). Evidence: TAS. Frequency: Frequent (HP:0040282). (ORPHA:79239)
- Oligomenorrhea (HP:0000876): Infrequent menses (less than 6 per year or more than 35 days between cycles). Evidence: TAS. Frequency: Frequent (HP:0040282). (ORPHA:79239)
- Jaundice (HP:0000952): Yellow pigmentation of the skin due to bilirubin, which in turn is the result of increased bilirubin concentration in the bloodstream. Evidence: TAS. Frequency: Frequent (HP:0040282). (ORPHA:79239)
- Mild intellectual disability (HP:0001256): Mild intellectual disability (ID) is defined as a type of ID characterized by mildly sub-average adaptive functioning and intellectual functioning, with an intelligence quotient (IQ) the range of 50-69. Evidence: TAS. Frequency: Frequent (HP:0040282). (ORPHA:79239)
- Global developmental delay (HP:0001263): A delay in the achievement of motor or mental milestones in the domains of development of a child, including motor skills, speech and language, cognitive skills, and social and emotional skills. This term should only be used to describe children younger than five years of age. Evidence: TAS. Frequency: Frequent (HP:0040282). (ORPHA:79239)
- Mental deterioration (HP:0001268): Loss of previously present mental abilities, generally in adults. Evidence: TAS. Frequency: Frequent (HP:0040282). (ORPHA:79239)
- Specific learning disability (HP:0001328): Impairment of certain skills such as reading or writing, coordination, self-control, or attention that interfere with the ability to learn. The impairment is not related to a global deficiency of intelligence. Evidence: TAS. Frequency: Frequent (HP:0040282). (ORPHA:79239)
- Hepatic failure (HP:0001399). Evidence: TAS. Frequency: Frequent (HP:0040282). (ORPHA:79239)
- Abnormality of coagulation (HP:0001928): An abnormality of the process of blood coagulation. That is, altered ability or inability of the blood to clot. Evidence: TAS. Frequency: Frequent (HP:0040282). (ORPHA:79239)
- Vomiting (HP:0002013): Forceful ejection of the contents of the stomach through the mouth by means of a series of involuntary spasmic contractions. Evidence: TAS. Frequency: Frequent (HP:0040282). (ORPHA:79239)
- Postural tremor (HP:0002174): A type of tremors that is triggered by holding a limb in a fixed position. Evidence: TAS. Frequency: Frequent (HP:0040282). (ORPHA:79239)
- Hepatomegaly (HP:0002240): Abnormally increased size of the liver. Evidence: TAS. Frequency: Frequent (HP:0040282). (ORPHA:79239)
- Action tremor (HP:0002345): A tremor present when the limbs are active, either when outstretched in a certain position or throughout a voluntary movement. Evidence: TAS. Frequency: Frequent (HP:0040282). (ORPHA:79239)
- Elevated circulating hepatic transaminase concentration (HP:0002910): Elevations of the levels of SGOT and SGPT in the serum. SGOT (serum glutamic oxaloacetic transaminase) and SGPT (serum glutamic pyruvic transaminase) are transaminases primarily found in the liver and heart and are released into the bloodstream as the result of liver or heart damage. SGOT and SGPT are used clinically mainly as markers of liver damage. Evidence: TAS. Frequency: Frequent (HP:0040282). (ORPHA:79239)
- Deficit in grammar (HP:0006977): Deficit in grammar, including syntax and morphology. Evidence: TAS. Frequency: Frequent (HP:0040282). (ORPHA:79239)
- Premature ovarian insufficiency (HP:0008209): Amenorrhea due to loss of ovarian function before the age of 40. Primary ovarian insuficiency (POI) is a state of female hypergonadotropic hypogonadism. It can manifest as primary amenorrhea with onset before menarche or secondary amenorrhea. Evidence: TAS. Frequency: Frequent (HP:0040282). (ORPHA:79239)
- Speech articulation difficulties (HP:0009088): Impairment in the physical production of speech sounds. Evidence: TAS. Frequency: Frequent (HP:0040282). (ORPHA:79239)
- Food intolerance (HP:0012537): A detrimental reaction to a food, beverage, food additive, or compound found in foods that produces symptoms in one or more body organs and systems that is not mediated by an immune reaction. Evidence: TAS. Frequency: Frequent (HP:0040282). (ORPHA:79239)
- Decreased circulating insulin-like growth factor 1 concentration (HP:0030353): The concentration of insulin-like growth factor 1 (IGF1) in the blood circulation is below the lower limit of normal. Evidence: TAS. Frequency: Frequent (HP:0040282). (ORPHA:79239)
- Cryptorchidism (HP:0000028): Testis in inguinal canal. That is, absence of one or both testes from the scrotum owing to failure of the testis or testes to descend through the inguinal canal to the scrotum. Evidence: TAS. Frequency: Occasional (HP:0040283). (ORPHA:79239)
- Depression (HP:0000716): Frequently experiencing feelings of being down, miserable, and/or hopeless; struggling to recover from these moods; having a pessimistic outlook on the future; feeling a pervasive sense of shame; having a low self-worth; experiencing thoughts of suicide and engaging in suicidal behavior. Evidence: TAS. Frequency: Occasional (HP:0040283). (ORPHA:79239)
- Autistic behavior (HP:0000729): Persistent deficits in social interaction and communication and interaction as well as a markedly restricted repertoire of activity and interest as well as repetitive patterns of behavior. Evidence: TAS. Frequency: Occasional (HP:0040283). (ORPHA:79239)
- Anxiety (HP:0000739): Intense feelings of nervousness, tension, or panic often arise in response to interpersonal stresses. There is worry about the negative effects of past unpleasant experiences and future negative possibilities. Individuals may feel fearful, apprehensive, or threatened by uncertainty, and they may also have fears of falling apart or losing control. Evidence: TAS. Frequency: Occasional (HP:0040283). (ORPHA:79239)
- Osteoporosis (HP:0000939): Osteoporosis is a systemic skeletal disease characterized by low bone density and microarchitectural deterioration of bone tissue with a consequent increase in bone fragility. According to the WHO criteria, osteoporosis is defined as a BMD that lies 2.5 standard deviations or more below the average value for young healthy adults (a T-score below -2.5 SD). Evidence: TAS. Frequency: Occasional (HP:0040283). (ORPHA:79239)
- Seizure (HP:0001250): A seizure is an intermittent abnormality of nervous system physiology characterized by a transient occurrence of signs and/or symptoms due to abnormal excessive or synchronous neuronal activity in the brain. Evidence: TAS. Frequency: Occasional (HP:0040283). (ORPHA:79239)
- Ataxia (HP:0001251): Ataxia refers to impaired coordination of voluntary muscle movement. Cerebellar ataxia refers to ataxia due to dysfunction of the cerebellum. This causes a variety of elementary neurological deficits including asynergy (lack of coordination between muscles, limbs and joints), dysmetria (lack of ability to judge distances that can lead to under- or overshoot in grasping movements), and dysdiadochokinesia (inability to perform rapid movements requiring antagonizing muscle groups to be switched on and off repeatedly). Evidence: TAS. Frequency: Occasional (HP:0040283). (ORPHA:79239)
- Lethargy (HP:0001254): A state of fatigue, either physical or mental slowness and sluggishness, with difficulties in initiating or performing simple tasks. Distinguished from apathy which implies indifference and a lack of desire or interest in the task. A person with lethargy may have the desire, but not the energy to engage in personal or socially relevant tasks. Evidence: TAS. Frequency: Occasional (HP:0040283). (ORPHA:79239)
- Dysarthria (HP:0001260): Dysarthric speech is a general description referring to a neurological speech disorder characterized by poor articulation. Depending on the involved neurological structures, dysarthria may be further classified as spastic, flaccid, ataxic, hyperkinetic and hypokinetic, or mixed. Evidence: TAS. Frequency: Occasional (HP:0040283). (ORPHA:79239)
- Gait disturbance (HP:0001288): The term gait disturbance can refer to any disruption of the ability to walk. Evidence: TAS. Frequency: Occasional (HP:0040283). (ORPHA:79239)
- Encephalopathy (HP:0001298): Encephalopathy is a term that means brain disease, damage, or malfunction. In general, encephalopathy is manifested by an altered mental state. Evidence: TAS. Frequency: Occasional (HP:0040283). (ORPHA:79239)
- Dystonia (HP:0001332): An abnormally increased muscular tone that causes fixed abnormal postures. There is a slow, intermittent twisting motion that leads to exaggerated turning and posture of the extremities and trunk. Evidence: TAS. Frequency: Occasional (HP:0040283). (ORPHA:79239)
- Hypoglycemia (HP:0001943): A decreased concentration of glucose in the blood. Evidence: TAS. Frequency: Occasional (HP:0040283). (ORPHA:79239)
- Diarrhea (HP:0002014): Abnormally increased frequency (usually defined as three or more) loose or watery bowel movements a day. Evidence: TAS. Frequency: Occasional (HP:0040283). (ORPHA:79239)
- Gait imbalance (HP:0002141). Evidence: TAS. Frequency: Occasional (HP:0040283). (ORPHA:79239)
- Incoordination (HP:0002311): A deficit in coordination of muscle movements. Coordination is defined as the orchestrated movement of multiple body parts as required to accomplish intended actions, like walking. Evidence: TAS. Frequency: Occasional (HP:0040283). (ORPHA:79239)
- Clumsiness (HP:0002312): Lack of physical coordination resulting in an abnormal tendency to drop items or bump into objects. Evidence: TAS. Frequency: Occasional (HP:0040283). (ORPHA:79239)
- Reduced bone mineral density (HP:0004349): A reduction of bone mineral density, that is, of the amount of matter per cubic centimeter of bones. Evidence: TAS. Frequency: Occasional (HP:0040283). (ORPHA:79239)
- Attention deficit hyperactivity disorder (HP:0007018): Attention deficit hyperactivity disorder (ADHD) manifests at age 2-3 years or by first grade at the latest. The main symptoms are distractibility, impulsivity, hyperactivity, and often trouble organizing tasks and projects, difficulty going to sleep, and social problems from being aggressive, loud, or impatient. Evidence: TAS. Frequency: Occasional (HP:0040283). (ORPHA:79239)
- Speech apraxia (HP:0011098): A type of apraxia that is characterized by difficulty or inability to execute speech movements because of problems with coordination and motor problems, leading to incorrect articulation. An increase of errors with increasing word and phrase length may occur. Evidence: TAS. Frequency: Occasional (HP:0040283). (ORPHA:79239)
- Abnormality of mental function (HP:0011446): Cognitive, psychiatric, or memory anomaly. Evidence: TAS. Frequency: Occasional (HP:0040283). (ORPHA:79239)
- Feeding difficulties (HP:0011968): Impaired ability to eat related to problems gathering food and getting ready to suck, chew, or swallow it. Evidence: TAS. Frequency: Occasional (HP:0040283). (ORPHA:79239)
- Bone fracture (HP:0020110): A partial or complete breakage of the continuity of a bone. Evidence: TAS. Frequency: Occasional (HP:0040283). (ORPHA:79239)
- Decreased circulating vitamin D concentration (HP:0100512): The concentration of vitamin D in the blood circulation is below the lower limit of normal. Evidence: TAS. Frequency: Occasional (HP:0040283). (ORPHA:79239)
- Sepsis (HP:0100806): Sepsis is defined as life-threatening organ dysfunction caused by a dysregulated host response to infection. Evidence: TAS. Frequency: Occasional (HP:0040283). (ORPHA:79239)
- Ascites (HP:0001541): Accumulation of fluid in the peritoneal cavity (between the layers of the peritoneum that lines the abdomen). Evidence: TAS. Frequency: Very rare (HP:0040284). (ORPHA:79239)
These phenotypes are associated with the disease Classic galactosemia (ORPHA:79239).